- Narrow mouth (HP:0000160): Distance between the commissures of the mouth more than 2 SD below the mean. Alternatively, an apparently decreased width of the oral aperture (subjective). Evidence: TAS. Frequency: Very frequent (HP:0040281). (ORPHA:1972)
- Microglossia (HP:0000171): Decreased length and width of the tongue. Evidence: TAS. Frequency: Very frequent (HP:0040281). (ORPHA:1972)
- Microretrognathia (HP:0000308): A form of developmental hypoplasia of the mandible in which the mandible is mislocalised posteriorly. Evidence: TAS. Frequency: Very frequent (HP:0040281). (ORPHA:1972)
- Intrauterine growth retardation (HP:0001511): An abnormal restriction of fetal growth with fetal weight below the tenth percentile for gestational age. Evidence: TAS. Frequency: Very frequent (HP:0040281). (ORPHA:1972)
- Patent ductus arteriosus (HP:0001643): In utero, the ductus arteriosus (DA) serves to divert ventricular output away from the lungs and toward the placenta by connecting the main pulmonary artery to the descending aorta. A patent ductus arteriosus (PDA) in the first 3 days of life is a physiologic shunt in healthy term and preterm newborn infants, and normally is substantially closed within about 24 hours after bith and completely closed after about three weeks. Failure of physiologcal closure is referred to a persistent or patent ductus arteriosus (PDA). Depending on the degree of left-to-right shunting, PDA can have clinical consequences. Evidence: TAS. Frequency: Frequent (HP:0040282). (ORPHA:1972)
- Sandal gap (HP:0001852): A widely spaced gap between the first toe (the great toe) and the second toe. Evidence: TAS. Frequency: Very frequent (HP:0040281). (ORPHA:1972)
- Hypoplasia of the radius (HP:0002984): Underdevelopment of the radius. Evidence: TAS. Frequency: Very frequent (HP:0040281). (ORPHA:1972)
- Hypoplasia of the ulna (HP:0003022): Underdevelopment of the ulna. Evidence: TAS. Frequency: Very frequent (HP:0040281). (ORPHA:1972)
- Fibular hypoplasia (HP:0003038): Underdevelopment of the fibula. Evidence: TAS. Frequency: Very frequent (HP:0040281). (ORPHA:1972)
- Radial ray deficiency (HP:0006433): Radial dysplasia, also known as radial longitudinal deficiency, includes radial clubhand and is a disfiguring, and potentially disabling, congenital limb anomaly. The entire upper limb may be involved, although the defect is most evident in the forearm and hand. Affected children suffer a variable degree of hypoplasia or absence of the preaxial skeleton and soft tissues, in particular the thumb, radius, and dorsoradial soft tissues. The hand is usually radially deviated and subluxated off the distal aspect of the ulna, the ulna may be shortened and have a bow-shaped deformity, and there is no true wrist (radiocarpal) joint in Bayne2 type-III and IV radial dysplasia. Evidence: TAS. Frequency: Very frequent (HP:0040281). (ORPHA:1972)
- Hypoplastic left ventricle (HP:0004383): A severe congenital heart defect characterized by underdevelopment of the left ventricle. Evidence: TAS. Frequency: Very frequent (HP:0040281). (ORPHA:1972)
- Short tibia (HP:0005736): Underdevelopment (reduced size) of the tibia. Evidence: TAS. Frequency: Very frequent (HP:0040281). (ORPHA:1972)
- Bilateral single transverse palmar creases (HP:0007598): The distal and proximal transverse palmar creases are merged into a single transverse palmar crease on both hands. Evidence: TAS. Frequency: Very frequent (HP:0040281). (ORPHA:1972)
- Short 5th finger (HP:0009237): Hypoplasia (congenital reduction in size) of the fifth finger, also known as the little finger. Evidence: TAS. Frequency: Very frequent (HP:0040281). (ORPHA:1972)
- Short thumb (HP:0009778): Hypoplasia (congenital reduction in size) of the thumb. Evidence: TAS. Frequency: Very frequent (HP:0040281). (ORPHA:1972)
These phenotypes are associated with the disease Lethal faciocardiomelic dysplasia (ORPHA:1972).